Phenotypes associated with the disease Tricho-retino-dento-digital syndrome (ORPHA:1264):
- Abnormality of the dentition (HP:0000164): Any abnormality of the teeth. Evidence: TAS. Frequency: Very frequent (HP:0040281). (ORPHA:1264)
- Juvenile cataract (HP:0001118): A type of cataract that is not apparent at birth but that arises in childhood or adolescence. Evidence: TAS. Frequency: Very frequent (HP:0040281). (ORPHA:1264)
- Brachydactyly (HP:0001156): Digits that appear disproportionately short compared to the hand/foot. The word brachydactyly is used here to describe a series distinct patterns of shortened digits (brachydactyly types A-E). This is the sense used here. Evidence: TAS. Frequency: Very frequent (HP:0040281). (ORPHA:1264)
- Abnormal retinal pigmentation (HP:0007703): Any deviation from the normal pigmentation of the retina. Evidence: TAS. Frequency: Very frequent (HP:0040281). (ORPHA:1264)
- Sparse hair (HP:0008070): Reduced density of hairs. Evidence: TAS. Frequency: Very frequent (HP:0040281). (ORPHA:1264)
- Uncombable hair (HP:0030056): Hair that is disorderly, stands out from the scalp, and cannot be combed flat. Evidence: TAS. Frequency: Very frequent (HP:0040281). (ORPHA:1264)
- Oligodontia (HP:0000677): The absence of six or more teeth from the normal series by a failure to develop. Evidence: TAS. Frequency: Frequent (HP:0040282). (ORPHA:1264)
- Abnormality of the hand (HP:0001155): An abnormality affecting one or both hands. Evidence: TAS. Frequency: Frequent (HP:0040282). (ORPHA:1264)
- Supernumerary tooth (HP:0011069): The presence of one or more teeth additional to the normal number. Evidence: TAS. Frequency: Frequent (HP:0040282). (ORPHA:1264)
- Short 5th metacarpal (HP:0010047): Short fifth metacarpal bone. Evidence: TAS. Frequency: Occasional (HP:0040283). (ORPHA:1264)